Phenotypes associated with the disease Primary hyperoxaluria type 3 (ORPHA:93600):
- Nephrocalcinosis (HP:0000121): Nephrocalcinosis is the deposition of calcium salts in renal parenchyma. Evidence: TAS. Frequency: Very frequent (HP:0040281). (ORPHA:93600)
- Hematuria (HP:0000790): The presence of blood in the urine. Hematuria may be gross hematuria (visible to the naked eye) or microscopic hematuria (detected by dipstick or microscopic examination of the urine). Evidence: TAS. Frequency: Very frequent (HP:0040281). (ORPHA:93600)
- Abnormality of urine homeostasis (HP:0003110): An abnormality of the composition of urine or the levels of its components. Evidence: TAS. Frequency: Very frequent (HP:0040281). (ORPHA:93600)
- Hyperoxaluria (HP:0003159): Increased excretion of oxalates in the urine. Evidence: TAS. Frequency: Very frequent (HP:0040281). (ORPHA:93600)
- Calcium oxalate nephrolithiasis (HP:0008672): The presence of calcium- and oxalate-containing calculi (stones) in the kidneys. Evidence: TAS. Frequency: Very frequent (HP:0040281). (ORPHA:93600)
- Abnormal renal physiology (HP:0012211): An abnormal functionality of the kidney. Evidence: TAS. Frequency: Very frequent (HP:0040281). (ORPHA:93600)
- Pain (HP:0012531): An unpleasant sensory and emotional experience associated with actual or potential tissue damage, or described in terms of such damage. Evidence: TAS. Frequency: Very frequent (HP:0040281). (ORPHA:93600)
- Pollakisuria (HP:0100515): Increased frequency of urination. Evidence: TAS. Frequency: Very frequent (HP:0040281). (ORPHA:93600)
- Dysuria (HP:0100518): Painful or difficult urination. Evidence: TAS. Frequency: Very frequent (HP:0040281). (ORPHA:93600)